- Developmental cataract (HP:0000519): A cataract that occurs congenitally as the result of a developmental defect, in contrast to the majority of cataracts that occur in adulthood as the result of degenerative changes of the lens. Evidence: IEA. (OMIM:115700)
- Autosomal dominant inheritance (HP:0000006): A mode of inheritance that is observed for traits related to a gene encoded on one of the autosomes (i.e., the human chromosomes 1-22) in which a trait manifests in heterozygotes. In the context of medical genetics, an autosomal dominant disorder is caused when a single copy of the mutant allele is present. Males and females are affected equally, and can both transmit the disorder with a risk of 50% for each child of inheriting the mutant allele. Evidence: IEA. (OMIM:115700)
These phenotypes are associated with the disease cataract 4 multiple types (OMIM:115700).